- Sensorineural hearing impairment (HP:0000407): A type of hearing impairment in one or both ears related to an abnormal functionality of the cochlear nerve. Evidence: IEA. (OMIM:124700)
- Childhood onset (HP:0011463): Onset of disease at the age of between 1 and 5 years. Evidence: IEA. (OMIM:124700)
- Progressive hearing impairment (HP:0001730): A progressive form of hearing impairment. Evidence: IEA. (OMIM:124700)
- Autosomal dominant inheritance (HP:0000006): A mode of inheritance that is observed for traits related to a gene encoded on one of the autosomes (i.e., the human chromosomes 1-22) in which a trait manifests in heterozygotes. In the context of medical genetics, an autosomal dominant disorder is caused when a single copy of the mutant allele is present. Males and females are affected equally, and can both transmit the disorder with a risk of 50% for each child of inheriting the mutant allele. Evidence: IEA. (OMIM:124700)
These phenotypes are associated with the disease deafness, mid-tone neural (OMIM:124700).